- Pulmonary venous hypertension (HP:0030950): An abnormal increase in pressure in the pulmonary veins, usually as a result of left atrial hypertension. Evidence: TAS. Frequency: Very frequent (HP:0040281). (ORPHA:1464)
- Valvular pulmonary stenosis (HP:0034350): A cardiovascular malformation associated with narrowing of the outflow tract of the right ventricle immediately at the level of the pulmonary valve. Evidence: TAS. Frequency: Very frequent (HP:0040281). (ORPHA:1464)
- Failure to thrive (HP:0001508): Failure to thrive (FTT) refers to a child whose physical growth is substantially below the norm. Evidence: TAS. Frequency: Frequent (HP:0040282). (ORPHA:1464)
- Congestive heart failure (HP:0001635): The presence of an abnormality of cardiac function that is responsible for the failure of the heart to pump blood at a rate that is commensurate with the needs of the tissues or a state in which abnormally elevated filling pressures are required for the heart to do so. Heart failure is frequently related to a defect in myocardial contraction. Evidence: TAS. Frequency: Frequent (HP:0040282). (ORPHA:1464)
- Respiratory distress (HP:0002098): Respiratory distress is objectively observable as the physical or emotional consequences from the experience of dyspnea. The physical presentation of respiratory distress is generally referred to as labored breathing, while the sensation of respiratory distress is called shortness of breath or dyspnea. Evidence: TAS. Frequency: Frequent (HP:0040282). (ORPHA:1464)
- Tachypnea (HP:0002789): Very rapid breathing. Evidence: TAS. Frequency: Frequent (HP:0040282). (ORPHA:1464)
- Hypoplastic left ventricle (HP:0004383): A severe congenital heart defect characterized by underdevelopment of the left ventricle. Evidence: TAS. Frequency: Frequent (HP:0040282). (ORPHA:1464)
- Heart murmur (HP:0030148): An extra or unusual sound heard during a heartbeat caused vibrations resulting from the flow of blood through the heart. Evidence: TAS. Frequency: Frequent (HP:0040282). (ORPHA:1464)
- Cyanosis (HP:0000961): Bluish discoloration of the skin and mucosa due to poor circulation or inadequate oxygenation of arterial or capillary blood. Evidence: TAS. Frequency: Occasional (HP:0040283). (ORPHA:1464)
- Cardiomegaly (HP:0001640): Increased size of the heart, clinically defined as an increased transverse diameter of the cardiac silhouette that is greater than or equal to 50% of the transverse diameter of the chest (increased cardiothoracic ratio) on a posterior-anterior projection of a chest radiograph or a computed tomography. Evidence: TAS. Frequency: Occasional (HP:0040283). (ORPHA:1464)
- Esophageal varix (HP:0002040): Extreme dilation of the submucusoal veins in the lower portion of the esophagus. Evidence: TAS. Frequency: Occasional (HP:0040283). (ORPHA:1464)
- Hepatomegaly (HP:0002240): Abnormally increased size of the liver. Evidence: TAS. Frequency: Occasional (HP:0040283). (ORPHA:1464)
- Arrhythmia (HP:0011675): Any cardiac rhythm other than the normal sinus rhythm. Such a rhythm may be either of sinus or ectopic origin and either regular or irregular. An arrhythmia may be due to a disturbance in impulse formation or conduction or both. Evidence: TAS. Frequency: Occasional (HP:0040283). (ORPHA:1464)
- Hypoxemia (HP:0012418): An abnormally low level of blood oxygen. Evidence: TAS. Frequency: Occasional (HP:0040283). (ORPHA:1464)
These phenotypes are associated with the disease Univentricular heart (ORPHA:1464).